Phenotypes associated with the disease Familial cylindromatosis (ORPHA:211):
- Subcutaneous nodule (HP:0001482): Slightly elevated lesions on or in the skin with a diameter of over 5 mm. Evidence: TAS. Frequency: Very frequent (HP:0040281). (ORPHA:211)
- Telangiectasia of the skin (HP:0100585): Presence of small, permanently dilated blood vessels near the surface of the skin, visible as small focal red lesions. Evidence: TAS. Frequency: Very frequent (HP:0040281). (ORPHA:211)